- Congenital onset (HP:0003577): A phenotypic abnormality that is present at birth. Evidence: IEA. (OMIM:613090)
- Hypochloremia (HP:0003113): The concentration of chloride in the blood circulation is below the lower limit of normal. Evidence: IEA. (OMIM:613090)
- Renal insufficiency (HP:0000083): A reduction in the level of performance of the kidneys in areas of function comprising the concentration of urine, removal of wastes, the maintenance of electrolyte balance, homeostasis of blood pressure, and calcium metabolism. Evidence: IEA. (OMIM:613090)
- Hypotonia (HP:0001252): Hypotonia is an abnormally low muscle tone (the amount of tension or resistance to movement in a muscle). Even when relaxed, muscles have a continuous and passive partial contraction which provides some resistance to passive stretching. Hypotonia thus manifests as diminished resistance to passive stretching. Hypotonia is not the same as muscle weakness, although the two conditions can co-exist. Evidence: IEA. (OMIM:613090)
- Generalized hypotonia (HP:0001290): Generalized muscular hypotonia (abnormally low muscle tone). Evidence: TAS. (OMIM:613090)
- Digenic inheritance (HP:0010984): A type of multifactorial inheritance governed by the simultaneous action of two gene loci. Evidence: TAS. (OMIM:613090)
- Motor delay (HP:0001270): A type of Developmental delay characterized by a delay in acquiring motor skills. Evidence: IEA. (OMIM:613090)
- Hypernatriuria (HP:0012605): An increased concentration of sodium(1+) in the urine. Evidence: IEA. (OMIM:613090)
- Failure to thrive (HP:0001508): Failure to thrive (FTT) refers to a child whose physical growth is substantially below the norm. Evidence: IEA. (OMIM:613090)
- Increased circulating aldosterone concentration (HP:0000859): Overproduction of the mineralocorticoid aldosterone by the adrenal cortex. Evidence: IEA. (OMIM:613090)
- Hyperchloriduria (HP:0002914): An increased concentration of chloride in the urine. Evidence: IEA. (OMIM:613090)
- Intellectual disability (HP:0001249): The term intellectual disability or intellectual developmental disorder is used to describe significantly sub-average intellectual and adaptive functioning based on clinical assessment and as measured by individually administered, appropriately normed, standardized and validated tests of intellectual functioning and adaptive behavior, with onset during the developmental period from infancy through adolescence. Evidence: IEA. (OMIM:613090)
- Premature birth (HP:0001622): The birth of a baby of less than 37 weeks of gestational age. Evidence: IEA. (OMIM:613090)
- Hyporeflexia (HP:0001265): Reduction of neurologic reflexes such as the knee-jerk reaction. Evidence: IEA. (OMIM:613090)
- Polyhydramnios (HP:0001561): The presence of excess amniotic fluid in the uterus during pregnancy. Evidence: TAS. (OMIM:613090)
- Fetal polyuria (HP:0001563): Abnormally increased production of urine by the fetus resulting in polyhydramnios. Evidence: IEA. (OMIM:613090)
- Decreased glomerular filtration rate (HP:0012213): An abnormal reduction in the volume of fluid filtered out of plasma through glomerular capillary walls into Bowman's capsules per unit of time. Evidence: TAS. (OMIM:613090)
- Increased urinary potassium (HP:0003081): An increased concentration of potassium(1+) in the urine. Evidence: IEA. (OMIM:613090)
- Edema (HP:0000969): An abnormal accumulation of fluid beneath the skin, or in one or more cavities of the body. Evidence: IEA. (OMIM:613090)
- Hypokalemic hypochloremic metabolic alkalosis (HP:0004909). Evidence: IEA. (OMIM:613090)
- Sensorineural hearing impairment (HP:0000407): A type of hearing impairment in one or both ears related to an abnormal functionality of the cochlear nerve. Evidence: IEA. (OMIM:613090)
- Hyponatremia (HP:0002902): The concentration of sodium in the blood circulation is below the lower limit of normal. Evidence: IEA. (OMIM:613090)
- Hypokalemia (HP:0002900): The concentration of potassium(1+) in the blood circulation is below the lower limit of normal. Evidence: IEA. (OMIM:613090)
- Polyuria (HP:0000103): An increased rate of urine production. Evidence: IEA. (OMIM:613090)
- Renal salt wasting (HP:0000127): A high concentration of one or more electrolytes in the urine in the presence of low serum concentrations of the electrolyte(s). Evidence: IEA. (OMIM:613090)
These phenotypes are associated with the disease Bartter disease type 4B (OMIM:613090).